Phenotypes associated with the disease autosomal recessive nonsyndromic hearing loss 65 (OMIM:610248):
- Hearing impairment (HP:0000365): A decreased magnitude of the sensory perception of sound. Evidence: IEA. (OMIM:610248)
- Infantile onset (HP:0003593): Onset of signs or symptoms of disease between 28 days to one year of life. Evidence: IEA. (OMIM:610248)
- Autosomal recessive inheritance (HP:0000007): A mode of inheritance that is observed for traits related to a gene encoded on one of the autosomes (i.e., the human chromosomes 1-22) in which a trait manifests in individuals with two pathogenic alleles, either homozygotes (two copies of the same mutant allele) or compound heterozygotes (whereby each copy of a gene has a distinct mutant allele). Evidence: IEA. (OMIM:610248)